- Syncope (HP:0001279): A transient loss of consciousness (i.e., characterized by a rapid onset, a short duration, and a spontaneous and complete recovery) due to cerebral hypoperfusion. Evidence: TAS. Frequency: Frequent (HP:0040282). (ORPHA:334)
- Palpitations (HP:0001962): A sensation that the heart is pounding or racing, which is a non-specific sign but may be a manifestation of arrhythmia. Evidence: TAS. Frequency: Frequent (HP:0040282). (ORPHA:334)
- Dyspnea (HP:0002094): Difficult or labored breathing. Dyspnea is a subjective feeling only the patient can rate, e.g., on a Borg scale. Evidence: TAS. Frequency: Frequent (HP:0040282). (ORPHA:334)
- Vertigo (HP:0002321): An abnormal sensation of spinning while the body is actually stationary. Evidence: TAS. Frequency: Frequent (HP:0040282). (ORPHA:334)
- Exercise intolerance (HP:0003546): A functional motor deficit where individuals whose responses to the challenges of exercise fail to achieve levels considered normal for their age and gender. Evidence: TAS. Frequency: Frequent (HP:0040282). (ORPHA:334)
- Atrial fibrillation (HP:0005110): An atrial arrhythmia characterized by disorganized atrial activity without discrete P waves on the surface EKG, but instead by an undulating baseline or more sharply circumscribed atrial deflections of varying amplitude an frequency ranging from 350 to 600 per minute. Evidence: TAS. Frequency: Frequent (HP:0040282). (ORPHA:334)
- Fatigue (HP:0012378): A subjective feeling of tiredness characterized by a lack of energy and motivation. Evidence: TAS. Frequency: Frequent (HP:0040282). (ORPHA:334)
- Chest pain (HP:0100749): An unpleasant sensation characterized by physical discomfort (such as pricking, throbbing, or aching) localized to the chest. Evidence: TAS. Frequency: Frequent (HP:0040282). (ORPHA:334)
- Myocardial infarction (HP:0001658): Necrosis of the myocardium caused by an obstruction of the blood supply to the heart and often associated with chest pain, shortness of breath, palpitations, and anxiety as well as characteristic EKG findings and elevation of serum markers including creatine kinase-MB fraction and troponin. Evidence: TAS. Frequency: Occasional (HP:0040283). (ORPHA:334)
- Thromboembolic stroke (HP:0001727): A cerebrovascular accident (stroke) that occurs because of thromboembolism. Evidence: TAS. Frequency: Occasional (HP:0040283). (ORPHA:334)
- Thromboembolism (HP:0001907): The formation of a blood clot inside a blood vessel that subsequently travels through the blood stream from the site where it formed to another location in the body, generally leading to vascular occlusion at the distant site. Evidence: TAS. Frequency: Occasional (HP:0040283). (ORPHA:334)
These phenotypes are associated with the disease Hereditary atrial fibrillation (ORPHA:334).